- Autosomal recessive inheritance (HP:0000007): A mode of inheritance that is observed for traits related to a gene encoded on one of the autosomes (i.e., the human chromosomes 1-22) in which a trait manifests in individuals with two pathogenic alleles, either homozygotes (two copies of the same mutant allele) or compound heterozygotes (whereby each copy of a gene has a distinct mutant allele). Evidence: IEA. (OMIM:276904)
- Vestibular hyporeflexia (HP:0001756): A general descriptive term that describes impaired functioning of the vestibular apparatus that leads to manifestations such as dizziness or postural imbalance. Evidence: IEA. (OMIM:276904)
- Rod-cone dystrophy (HP:0000510): An inherited retinal disease subtype in which the rod photoreceptors appear to be more severely affected than the cone photoreceptors. Typical presentation is with nyctalopia (due to rod dysfunction) followed by loss of mid-peripheral field of vision, which gradually extends and leaves many patients with a small central island of vision due to the preservation of macular cones. Evidence: IEA. (OMIM:276904)
- Congenital sensorineural hearing impairment (HP:0008527): A type of hearing impairment caused by an abnormal functionality of the cochlear nerve with congenital onset. Evidence: TAS. (OMIM:276904)
These phenotypes are associated with the disease Usher syndrome type 1C (OMIM:276904).